Phenotypes associated with the disease intellectual disability, autosomal recessive 16 (OMIM:614208):
- Seizure (HP:0001250): A seizure is an intermittent abnormality of nervous system physiology characterized by a transient occurrence of signs and/or symptoms due to abnormal excessive or synchronous neuronal activity in the brain. Evidence: TAS. (OMIM:614208)
- Autosomal recessive inheritance (HP:0000007): A mode of inheritance that is observed for traits related to a gene encoded on one of the autosomes (i.e., the human chromosomes 1-22) in which a trait manifests in individuals with two pathogenic alleles, either homozygotes (two copies of the same mutant allele) or compound heterozygotes (whereby each copy of a gene has a distinct mutant allele). Evidence: TAS. (OMIM:614208)
- Synophrys (HP:0000664): Meeting of the medial eyebrows in the midline. Evidence: TAS. (OMIM:614208)
- Intellectual disability (HP:0001249): The term intellectual disability or intellectual developmental disorder is used to describe significantly sub-average intellectual and adaptive functioning based on clinical assessment and as measured by individually administered, appropriately normed, standardized and validated tests of intellectual functioning and adaptive behavior, with onset during the developmental period from infancy through adolescence. Evidence: TAS. (OMIM:614208)